- Abnormality of metabolism/homeostasis (HP:0001939). Evidence: IEA. (OMIM:190200)
- Ataxia (HP:0001251): Ataxia refers to impaired coordination of voluntary muscle movement. Cerebellar ataxia refers to ataxia due to dysfunction of the cerebellum. This causes a variety of elementary neurological deficits including asynergy (lack of coordination between muscles, limbs and joints), dysmetria (lack of ability to judge distances that can lead to under- or overshoot in grasping movements), and dysdiadochokinesia (inability to perform rapid movements requiring antagonizing muscle groups to be switched on and off repeatedly). Evidence: IEA. (OMIM:190200)
- Premature graying of hair (HP:0002216): Development of gray hair at a younger than normal age. Evidence: IEA. (OMIM:190200)
- Intention tremor (HP:0002080): A type of kinetic tremor that occurs during target directed movement is called intention tremor. That is, an oscillatory cerebellar ataxia that tends to be absent when the limbs are inactive and during the first part of voluntary movement but worsening as the movement continues and greater precision is required (e.g., in touching a target such as the patient's nose or a physician's finger). Evidence: IEA. (OMIM:190200)
- Autosomal dominant inheritance (HP:0000006): A mode of inheritance that is observed for traits related to a gene encoded on one of the autosomes (i.e., the human chromosomes 1-22) in which a trait manifests in heterozygotes. In the context of medical genetics, an autosomal dominant disorder is caused when a single copy of the mutant allele is present. Males and females are affected equally, and can both transmit the disorder with a risk of 50% for each child of inheriting the mutant allele. Evidence: IEA. (OMIM:190200)
These phenotypes are associated with the disease tremor of intention, ataxia, and lipofuscinosis (OMIM:190200).